- Triphalangeal thumb (HP:0001199): A thumb with three phalanges in a single, proximo-distal axis. Thus, this term applies if the thumb has an accessory phalanx, leading to a digit like appearance of the thumb. Evidence: IEA. (OMIM:190680)
- Short 3rd toe (HP:0005643): Underdevelopment (hypoplasia) of the third toe. Evidence: IEA. (OMIM:190680)
- Brachydactyly (HP:0001156): Digits that appear disproportionately short compared to the hand/foot. The word brachydactyly is used here to describe a series distinct patterns of shortened digits (brachydactyly types A-E). This is the sense used here. Evidence: IEA. (OMIM:190680)
- Split foot (HP:0001839): A condition in which middle parts of the foot (toes and metatarsals) are missing giving a cleft appearance. The severity is very variable ranging from slightly hypoplastic 3rd toe over absent 2nd or 3rd toes as far as oligo- or monodactyl feet. Evidence: TAS. (OMIM:190680)
- Split hand (HP:0001171): A condition in which middle parts of the hand (fingers and metacarpals) are missing giving a cleft appearance. The severity is very variable ranging from slightly hypoplastic middle fingers over absent middle fingers as far as oligo- or monodactyl hands. Evidence: TAS. (OMIM:190680)
- Short 2nd finger (HP:0009536): Hypoplasia of the second finger, also known as the index finger. Evidence: TAS. (OMIM:190680)
- Autosomal dominant inheritance (HP:0000006): A mode of inheritance that is observed for traits related to a gene encoded on one of the autosomes (i.e., the human chromosomes 1-22) in which a trait manifests in heterozygotes. In the context of medical genetics, an autosomal dominant disorder is caused when a single copy of the mutant allele is present. Males and females are affected equally, and can both transmit the disorder with a risk of 50% for each child of inheriting the mutant allele. Evidence: IEA. (OMIM:190680)
These phenotypes are associated with the disease triphalangeal thumbs-brachyectrodactyly syndrome (OMIM:190680).